- Decreased total leukocyte count (HP:0001882): An abnormal decreased number of leukocytes in the blood. Evidence: TAS. (OMIM:310350)
- X-linked recessive inheritance (HP:0001419): A mode of inheritance that is observed for recessive traits related to a gene encoded on the X chromosome. In the context of medical genetics, X-linked recessive disorders manifest in males (who have one copy of the X chromosome and are thus hemizygotes), but generally not in female heterozygotes who have one mutant and one normal allele. Evidence: TAS. (OMIM:310350)
- Recurrent bacterial infections (HP:0002718): Increased susceptibility to bacterial infections as manifested by recurrent episodes of bacterial infection. Evidence: TAS. (OMIM:310350)
- Recurrent viral infections (HP:0004429): Increased susceptibility to viral infections as manifested by recurrent episodes of viral infection. Evidence: TAS. (OMIM:310350)
- Hyposegmentation of neutrophil nuclei (HP:0011447): Hyposegmented (hypolobulated) or bilobed neutrophil nuclei. Evidence: TAS. (OMIM:310350)
These phenotypes are associated with the disease myelolymphatic insufficiency (OMIM:310350).